- Narrow forehead (HP:0000341): Width of the forehead or distance between the frontotemporales is more than two standard deviations below the mean (objective); or apparently narrow intertemporal region (subjective). Evidence: PCS. Frequency: 1/4. (PMID:25533962)
- Congenital hip dislocation (HP:0001374). Evidence: PCS. Frequency: 1/4. (PMID:25533962)
- Strabismus (HP:0000486): A misalignment of the eyes so that the visual axes deviate from bifoveal fixation. The classification of strabismus may be based on a number of features including the relative position of the eyes, whether the deviation is latent or manifest, intermittent or constant, concomitant or otherwise and according to the age of onset and the relevance of any associated refractive error. Evidence: PCS. Frequency: 2/15. (PMID:26168268;PMID:25533962)
- Pyloric stenosis (HP:0002021): Pyloric stenosis, also known as infantile hypertrophic pyloric stenosis, is an uncommon condition in infants characterized by abnormal thickening of the pylorus muscles in the stomach leading to gastric outlet obstruction. Clinically infants are well at birth. Then, at 3 to 6 weeks of age, the infants present with projectile vomiting, potentially leading to dehydration and weight loss. Evidence: PCS. Frequency: 1/4. (PMID:25533962)
- Seizure (HP:0001250): A seizure is an intermittent abnormality of nervous system physiology characterized by a transient occurrence of signs and/or symptoms due to abnormal excessive or synchronous neuronal activity in the brain. Evidence: PCS. Frequency: 1/4. (PMID:25533962)
- Gait ataxia (HP:0002066): A type of ataxia characterized by the impairment of the ability to coordinate the movements required for normal walking. Gait ataxia is characteirzed by a wide-based staggering gait with a tendency to fall. Evidence: PCS. Frequency: 5/9. (PMID:26168268)
- Hypotonia (HP:0001252): Hypotonia is an abnormally low muscle tone (the amount of tension or resistance to movement in a muscle). Even when relaxed, muscles have a continuous and passive partial contraction which provides some resistance to passive stretching. Hypotonia thus manifests as diminished resistance to passive stretching. Hypotonia is not the same as muscle weakness, although the two conditions can co-exist. Evidence: PCS. Frequency: 10/10. (PMID:26168268)
- Generalized hypotonia (HP:0001290): Generalized muscular hypotonia (abnormally low muscle tone). Evidence: PCS. Frequency: 1/4. (PMID:25533962)
- Hypertelorism (HP:0000316): Interpupillary distance more than 2 SD above the mean (alternatively, the appearance of an increased interpupillary distance or widely spaced eyes). Evidence: TAS. (OMIM:616355)
- Hydrocephalus (HP:0000238): Hydrocephalus is an active distension of the ventricular system of the brain resulting from inadequate passage of CSF from its point of production within the cerebral ventricles to its point of absorption into the systemic circulation. Evidence: PCS. Frequency: 2/15. (PMID:26168268;PMID:25533962)
- Hypoglycemia (HP:0001943): A decreased concentration of glucose in the blood. Evidence: PCS. Frequency: 1/4. (PMID:25533962)
- Ventriculomegaly (HP:0002119): An increase in size of the ventricular system of the brain. Evidence: PCS. Frequency: 3/15. (PMID:26168268;PMID:25533962)
- Macrocephaly (HP:0000256): Occipitofrontal (head) circumference greater than 97th centile compared to appropriate, age matched, sex-matched normal standards. Alternatively, a apparently increased size of the cranium. Evidence: PCS. Frequency: 1/4. (PMID:25533962)
- Congenital muscular torticollis (HP:0005988): A congenital form of torticollis resulting from shortening of the sternocleidomastoid muscle and leading to a limited range of motion in both rotation and lateral bending. Evidence: PCS. Frequency: 1/4. (PMID:25533962)
- Intellectual disability (HP:0001249): The term intellectual disability or intellectual developmental disorder is used to describe significantly sub-average intellectual and adaptive functioning based on clinical assessment and as measured by individually administered, appropriately normed, standardized and validated tests of intellectual functioning and adaptive behavior, with onset during the developmental period from infancy through adolescence. Evidence: PCS. Frequency: 15/15. (PMID:26168268;PMID:25533962)
- Facial hypotonia (HP:0000297): Reduced muscle tone of a muscle that is innervated by the facial nerve (the seventh cranial nerve). Evidence: TAS. (OMIM:616355)
- Downslanted palpebral fissures (HP:0000494): The palpebral fissure inclination is more than two standard deviations below the mean. Evidence: PCS. Frequency: 1/4. (PMID:25533962)
- Absent speech (HP:0001344): Complete lack of development of speech and language abilities. Evidence: PCS. Frequency: 5/11. (PMID:26168268)
- Delayed speech and language development (HP:0000750): A degree of language development that is significantly below the norm for a child of a specified age. Evidence: PCS. Frequency: 11/11. (PMID:26168268)
- Scoliosis (HP:0002650): The presence of an abnormal lateral curvature of the spine. Evidence: PCS. Frequency: 2/11. (PMID:26168268)
- Delayed ability to walk (HP:0031936): A failure to achieve the ability to walk at an appropriate developmental stage. Most children learn to walk in a series of stages, and learn to walk short distances independently between 12 and 15 months. Evidence: PCS. Frequency: 9/11. (PMID:26168268)
- Open mouth (HP:0000194): A facial appearance characterized by a permanently or nearly permanently opened mouth. Evidence: TAS. (OMIM:616355)
- Deeply set eye (HP:0000490): An eye that is more deeply recessed into the plane of the face than is typical. Evidence: PCS. Frequency: 1/4. (PMID:25533962)
- Global developmental delay (HP:0001263): A delay in the achievement of motor or mental milestones in the domains of development of a child, including motor skills, speech and language, cognitive skills, and social and emotional skills. This term should only be used to describe children younger than five years of age. Evidence: PCS. Frequency: 3/4. (PMID:25533962)
- Fatigue (HP:0012378): A subjective feeling of tiredness characterized by a lack of energy and motivation. Evidence: PCS. Frequency: 2/11. (PMID:26168268)
- Multifocal seizures (HP:0031165): Seizures that start from several different areas of the brain (i.e., with multiple ictal onset locations). Evidence: PCS. Frequency: 2/11. (PMID:26168268)
- Ptosis (HP:0000508): The upper eyelid margin is positioned 3 mm or more lower than usual and covers the superior portion of the iris (objective); or, the upper lid margin obscures at least part of the pupil (subjective). Evidence: PCS. Frequency: 1/11. (PMID:26168268)
- Intrauterine growth retardation (HP:0001511): An abnormal restriction of fetal growth with fetal weight below the tenth percentile for gestational age. Evidence: PCS. Frequency: 1/11. Onset: Congenital onset (HP:0003577). (PMID:26168268)
- Autosomal dominant inheritance (HP:0000006): A mode of inheritance that is observed for traits related to a gene encoded on one of the autosomes (i.e., the human chromosomes 1-22) in which a trait manifests in heterozygotes. In the context of medical genetics, an autosomal dominant disorder is caused when a single copy of the mutant allele is present. Males and females are affected equally, and can both transmit the disorder with a risk of 50% for each child of inheriting the mutant allele. Evidence: PCS. (PMID:25533962)
- Myopia (HP:0000545): An abnormality of refraction characterized by the ability to see objects nearby clearly, while objects in the distance appear blurry. Evidence: PCS. Frequency: 1/4. (PMID:25533962)
- Chronic diarrhea (HP:0002028): The presence of chronic diarrhea, which is usually taken to mean diarrhea that has persisted for over 4 weeks. Evidence: PCS. Frequency: 1/4. (PMID:25533962)
These phenotypes are associated with the disease Houge-Janssens syndrome 1 (OMIM:616355).